Phenotypes associated with the disease developmental and epileptic encephalopathy, 30 (OMIM:616341):
- Encephalopathy (HP:0001298): Encephalopathy is a term that means brain disease, damage, or malfunction. In general, encephalopathy is manifested by an altered mental state. Evidence: TAS. (OMIM:616341)
- Bilateral tonic-clonic seizure (HP:0002069): A bilateral tonic-clonic seizure is a seizure defined by a tonic (bilateral increased tone, lasting seconds to minutes) and then a clonic (bilateral sustained rhythmic jerking) phase. Evidence: TAS. (OMIM:616341)
- Hypsarrhythmia (HP:0002521): Hypsarrhythmia is abnormal interictal high amplitude waves and a background of irregular spikes. There is continuous (during wakefulness), high-amplitude (>200 Hz), generalized polymorphic slowing with no organized background and multifocal spikes demonstrated by electroencephalography (EEG). Evidence: TAS. (OMIM:616341)
- Absent speech (HP:0001344): Complete lack of development of speech and language abilities. Evidence: PCS. Frequency: 4/4. (PMID:25839329)
- Generalized myoclonic seizure (HP:0002123): A generalized myoclonic seizure is a type of generalized motor seizure characterized by bilateral, sudden, brief (<100 ms) involuntary single or multiple contraction of muscles or muscle groups of variable topography (axial, proximal limb, distal). Myoclonus is less regularly repetitive and less sustained than is clonus. Evidence: PCS. Frequency: 2/6. (PMID:25839329)
- Feeding difficulties (HP:0011968): Impaired ability to eat related to problems gathering food and getting ready to suck, chew, or swallow it. Evidence: PCS. (PMID:25839329)
- Seizure (HP:0001250): A seizure is an intermittent abnormality of nervous system physiology characterized by a transient occurrence of signs and/or symptoms due to abnormal excessive or synchronous neuronal activity in the brain. Evidence: PCS. Frequency: 6/6. Onset: Infantile onset (HP:0003593). (PMID:25839329)
- Respiratory distress (HP:0002098): Respiratory distress is objectively observable as the physical or emotional consequences from the experience of dyspnea. The physical presentation of respiratory distress is generally referred to as labored breathing, while the sensation of respiratory distress is called shortness of breath or dyspnea. Evidence: PCS. Frequency: 3/6. (PMID:25839329)
- Global developmental delay (HP:0001263): A delay in the achievement of motor or mental milestones in the domains of development of a child, including motor skills, speech and language, cognitive skills, and social and emotional skills. This term should only be used to describe children younger than five years of age. Evidence: PCS. Frequency: 4/4. (PMID:25839329)
- Motor stereotypy (HP:0000733): Use of the same abnormal action in response to certain triggers or at random. They may be used as a way to regulate one's internal state but must otherwise have no apparent functional purpose. Evidence: PCS. Frequency: 4/4. (PMID:25839329)
- Epileptic encephalopathy (HP:0200134): A condition in which epileptiform abnormalities are believed to contribute to the progressive disturbance in cerebral function. Epileptic encephalaopathy is characterized by (1) electrographic EEG paroxysmal activity that is often aggressive, (2) seizures that are usually multiform and intractable, (3) cognitive, behavioral and neurological deficits that may be relentless, and (4) sometimes early death. Evidence: IEA. (OMIM:616341)
- Death in infancy (HP:0001522): Death within the first 24 months of life. Evidence: PCS. Frequency: 2/6. (PMID:25839329)
- Autosomal dominant inheritance (HP:0000006): A mode of inheritance that is observed for traits related to a gene encoded on one of the autosomes (i.e., the human chromosomes 1-22) in which a trait manifests in heterozygotes. In the context of medical genetics, an autosomal dominant disorder is caused when a single copy of the mutant allele is present. Males and females are affected equally, and can both transmit the disorder with a risk of 50% for each child of inheriting the mutant allele. Evidence: PCS. (PMID:25839329)